- Sensorineural hearing impairment (HP:0000407): A type of hearing impairment in one or both ears related to an abnormal functionality of the cochlear nerve. Evidence: PCS. Frequency: 9/9. Onset: Infantile onset (HP:0003593). (PMID:25941349)
- Autosomal recessive inheritance (HP:0000007): A mode of inheritance that is observed for traits related to a gene encoded on one of the autosomes (i.e., the human chromosomes 1-22) in which a trait manifests in individuals with two pathogenic alleles, either homozygotes (two copies of the same mutant allele) or compound heterozygotes (whereby each copy of a gene has a distinct mutant allele). Evidence: PCS. (PMID:25941349)
These phenotypes are associated with the disease autosomal recessive nonsyndromic hearing loss 97 (OMIM:616705).